- Hypoplasia of the maxilla (HP:0000327): Abnormally small dimension of the Maxilla. Usually creating a malocclusion or malalignment between the upper and lower teeth or resulting in a deficient amount of projection of the base of the nose and lower midface region. Evidence: TAS. Frequency: Frequent (HP:0040282). (ORPHA:664372)
- Dental malocclusion (HP:0000689): Dental malocclusion refers to an abnormality of the occlusion, or alignment, of the teeth and the way the upper and lower teeth fit together, resulting in overcrowding of teeth or in abnormal bite patterns. Evidence: TAS. Frequency: Frequent (HP:0040282). (ORPHA:664372)
- Hypernasal speech (HP:0001611): A type of speech characterized by the presence of an abnormally increased nasal airflow during speech associated with structural abnormality of the nasal passages. Evidence: TAS. Frequency: Frequent (HP:0040282). (ORPHA:664372)
- Micrognathia (HP:0000347): Developmental hypoplasia of the mandible. Evidence: TAS. Frequency: Occasional (HP:0040283). (ORPHA:664372)
These phenotypes are associated with the disease Soft and hard cleft palate (ORPHA:664372).